Phenotypes associated with the disease PDA1 (OMIM:607411):
- Autosomal recessive inheritance (HP:0000007): A mode of inheritance that is observed for traits related to a gene encoded on one of the autosomes (i.e., the human chromosomes 1-22) in which a trait manifests in individuals with two pathogenic alleles, either homozygotes (two copies of the same mutant allele) or compound heterozygotes (whereby each copy of a gene has a distinct mutant allele). Evidence: TAS. (OMIM:607411)
- Patent ductus arteriosus (HP:0001643): In utero, the ductus arteriosus (DA) serves to divert ventricular output away from the lungs and toward the placenta by connecting the main pulmonary artery to the descending aorta. A patent ductus arteriosus (PDA) in the first 3 days of life is a physiologic shunt in healthy term and preterm newborn infants, and normally is substantially closed within about 24 hours after bith and completely closed after about three weeks. Failure of physiologcal closure is referred to a persistent or patent ductus arteriosus (PDA). Depending on the degree of left-to-right shunting, PDA can have clinical consequences. Evidence: TAS. (OMIM:607411)